- Bronchoconstriction (HP:4000007): Tightening of smooth muscle surrounding the bronchi and bronchioles with consequent wheezing and shortness of breath. Evidence: TAS. Frequency: Occasional (HP:0040283). (ORPHA:100093)
- Erythematous plaque (HP:0025474): A plaque (a solid, raised, plateau-like (flat-topped) lesion greater than 1 cm in diameter) with a red or reddish color often associated with inflammation or irritation. Evidence: TAS. Frequency: Frequent (HP:0040282). (ORPHA:100093)
- Night sweats (HP:0030166): Occurrence of excessive sweating during sleep. Evidence: TAS. Frequency: Frequent (HP:0040282). (ORPHA:100093)
- Right ventricular failure (HP:0001708): Reduced ability of the right ventricle to perform its function (to receive blood from the right atrium and to eject blood into the pulmonary artery), often leading to pitting peripheral edema, ascites, and hepatomegaly. Evidence: TAS. Frequency: Occasional (HP:0040283). (ORPHA:100093)
- Palpitations (HP:0001962): A sensation that the heart is pounding or racing, which is a non-specific sign but may be a manifestation of arrhythmia. Evidence: TAS. Frequency: Occasional (HP:0040283). (ORPHA:100093)
- Nausea and vomiting (HP:0002017): Nausea is a commonly encountered symptom that has been defined as an unpleasant painless subjective feeling that one will imminently vomit. Vomiting has been defined as the forceful expulsion of the contents of the stomach, duodenum, or jejunum through the oral cavity. While nausea and vomiting are often thought to exist on a temporal continuum, this is not always the case. There are situations when severe nausea may be present without emesis and less frequently, when emesis may be present without preceding nausea. Evidence: TAS. Frequency: Occasional (HP:0040283). (ORPHA:100093)
- Asthma (HP:0002099): Asthma is characterized by increased responsiveness of the tracheobronchial tree to multiple stimuli, leading to narrowing of the air passages with resultant dyspnea, cough, and wheezing. Evidence: TAS. Frequency: Occasional (HP:0040283). (ORPHA:100093)
- Chronic noninfectious lymphadenopathy (HP:0002730): A chronic form of lymphadenopathy that is not related to infection. Evidence: TAS. Frequency: Occasional (HP:0040283). (ORPHA:100093)
- Elevated circulating hepatic transaminase concentration (HP:0002910): Elevations of the levels of SGOT and SGPT in the serum. SGOT (serum glutamic oxaloacetic transaminase) and SGPT (serum glutamic pyruvic transaminase) are transaminases primarily found in the liver and heart and are released into the bloodstream as the result of liver or heart damage. SGOT and SGPT are used clinically mainly as markers of liver damage. Evidence: TAS. Frequency: Occasional (HP:0040283). (ORPHA:100093)
- Increased serum serotonin (HP:0003144): A increased concentration of serotonin in the blood. Evidence: TAS. Frequency: Occasional (HP:0040283). (ORPHA:100093)
- Tricuspid regurgitation (HP:0005180): Failure of the tricuspid valve to close sufficiently upon contraction of the right ventricle, causing blood to regurgitate (flow backward) into the right atrium. Evidence: TAS. Frequency: Occasional (HP:0040283). (ORPHA:100093)
- Facial telangiectasia (HP:0007380): Telangiectases (small dilated blood vessels) located near the surface of the skin of the face. Evidence: TAS. Frequency: Occasional (HP:0040283). (ORPHA:100093)
- Epiphora (HP:0009926): Abnormally increased lacrimation, that is, excessive tearing (watering eye). Evidence: TAS. Frequency: Occasional (HP:0040283). (ORPHA:100093)
- Heart murmur (HP:0030148): An extra or unusual sound heard during a heartbeat caused vibrations resulting from the flow of blood through the heart. Evidence: TAS. Frequency: Occasional (HP:0040283). (ORPHA:100093)
- Pulmonary carcinoid tumor (HP:0030445): A malignant neuroendocrine tumor of the lung. According to histopathologic criteria (WHO 2004), carcinoids are divided into four groups i.e. typical and atypical carcinoids, large cell neuroendocrine carcinoma and small cell lung carcinoma. Evidence: TAS. Frequency: Occasional (HP:0040283). (ORPHA:100093)
- Abnormal circulating B-type natriuretic peptide concentration (HP:0031138): A deviation from the normal circulating concentration of B-type natriuretic peptide (BNP). Evidence: TAS. Frequency: Occasional (HP:0040283). (ORPHA:100093)
- Rhinorrhea (HP:0031417): Increased discharge of mucus from the nose. Evidence: TAS. Frequency: Occasional (HP:0040283). (ORPHA:100093)
- Hepatic necrosis (HP:0002605): The presence of cell death (necrosis) affecting the liver. Evidence: TAS. Frequency: Very rare (HP:0040284). (ORPHA:100093)
- Paraganglioma (HP:0002668): A carotid body tumor (also called paraganglionoma or chemodectoma) is a tumor found in the upper neck at the branching of the carotid artery. They arise from the chemoreceptor organ (paraganglion) located in the adventitia of the carotid artery bifurcation. Evidence: TAS. Frequency: Very rare (HP:0040284). (ORPHA:100093)
- Myopathy (HP:0003198): A disorder of muscle unrelated to impairment of innervation or neuromuscular junction. Evidence: TAS. Frequency: Very rare (HP:0040284). (ORPHA:100093)
- Lack of bowel sounds (HP:0030145): Complete lack of abdominal sounds as assayed by examination of the abdomen with a stethoscope. Evidence: TAS. Frequency: Very rare (HP:0040284). (ORPHA:100093)
- Atypical pulmonary carcinoid tumor (HP:0030446). Evidence: TAS. Frequency: Very rare (HP:0040284). (ORPHA:100093)
- Carcinoid tumor (HP:0100570): A tumor formed from the endocrine (argentaffin) cells of the mucosal lining of a variety of organs including the stomach and intestine. These cells are from neuroectodermal origin. Evidence: TAS. Frequency: Obligate (HP:0040280). (ORPHA:100093)
- Episodic abdominal pain (HP:0002574): An intermittent form of abdominal pain. Evidence: TAS. Frequency: Frequent (HP:0040282). (ORPHA:100093)
- Protracted diarrhea (HP:0004385). Evidence: TAS. Frequency: Frequent (HP:0040282). (ORPHA:100093)
- Small intestine carcinoid (HP:0006722). Evidence: TAS. Frequency: Frequent (HP:0040282). (ORPHA:100093)
- Intestinal carcinoid (HP:0006723). Evidence: TAS. Frequency: Frequent (HP:0040282). (ORPHA:100093)
These phenotypes are associated with the disease Carcinoid syndrome (ORPHA:100093).